Phenotypes associated with the disease autosomal recessive nonsyndromic hearing loss 31 (OMIM:607084):
- Congenital onset (HP:0003577): A phenotypic abnormality that is present at birth. Evidence: PCS. Frequency: 4/4. (PMID:15841483)
- Sensorineural hearing impairment (HP:0000407): A type of hearing impairment in one or both ears related to an abnormal functionality of the cochlear nerve. Evidence: PCS. Frequency: 6/6. (PMID:12833159)
- Sensorineural hearing impairment (HP:0000407): A type of hearing impairment in one or both ears related to an abnormal functionality of the cochlear nerve. Evidence: PCS. Frequency: 4/4. Onset: Congenital onset (HP:0003577). (PMID:15841483)
- Autosomal recessive inheritance (HP:0000007): A mode of inheritance that is observed for traits related to a gene encoded on one of the autosomes (i.e., the human chromosomes 1-22) in which a trait manifests in individuals with two pathogenic alleles, either homozygotes (two copies of the same mutant allele) or compound heterozygotes (whereby each copy of a gene has a distinct mutant allele). Evidence: PCS. (PMID:12833159)
- Absent vestibular function (HP:0008555): Complete lack of functioning of the vestibular apparatus. Evidence: PCS. Frequency: 0/4. (PMID:15841483)